Phenotypes associated with the disease Oligodontia (ORPHA:99798):
- Oligodontia (HP:0000677): The absence of six or more teeth from the normal series by a failure to develop. Evidence: TAS. Frequency: Obligate (HP:0040280). (ORPHA:99798)
- Impaired mastication (HP:0005216): An abnormal reduction in the ability to masticate (chew), i.e., in the ability to crush and ground food in preparation for swallowing. Evidence: TAS. Frequency: Very frequent (HP:0040281). (ORPHA:99798)
- Delayed eruption of teeth (HP:0000684): Delayed tooth eruption, which can be defined as tooth eruption more than 2 SD beyond the mean eruption age. Evidence: TAS. Frequency: Frequent (HP:0040282). (ORPHA:99798)
- Widely spaced teeth (HP:0000687): Increased spaces (diastemata) between most of the teeth in the same dental arch. Evidence: TAS. Frequency: Frequent (HP:0040282). (ORPHA:99798)
- Dental malocclusion (HP:0000689): Dental malocclusion refers to an abnormality of the occlusion, or alignment, of the teeth and the way the upper and lower teeth fit together, resulting in overcrowding of teeth or in abnormal bite patterns. Evidence: TAS. Frequency: Frequent (HP:0040282). (ORPHA:99798)
- Agenesis of maxillary lateral incisor (HP:0000690): Agenesis of one or more maxillary lateral incisor, comprising the maxillary lateral primary incisor and maxillary lateral secondary incisor. Evidence: TAS. Frequency: Frequent (HP:0040282). (ORPHA:99798)
- Microdontia (HP:0000691): Decreased size of the teeth, which can be defined as a mesiodistal tooth diameter (width) more than 2 SD below mean. Alternatively, an apparently decreased maximum width of tooth. Evidence: TAS. Frequency: Frequent (HP:0040282). (ORPHA:99798)
- Delayed eruption of permanent teeth (HP:0000696): Delayed tooth eruption affecting the secondary dentition. Evidence: TAS. Frequency: Frequent (HP:0040282). (ORPHA:99798)
- Agenesis of central incisor (HP:0006289): Agenesis of one or more central incisors, i.e., of lower secondary incisor, lower primary incisor, upper secondary incisor, or of upper central primary incisor. Evidence: TAS. Frequency: Frequent (HP:0040282). (ORPHA:99798)
- Short dental root (HP:0006336): Tooth root length more than 2 SD below mean, or subjectively apparently decreased tooth root length. Evidence: TAS. Frequency: Frequent (HP:0040282). (ORPHA:99798)
- Agenesis of premolar (HP:0011051): Agenesis of premolar tooth. Evidence: TAS. Frequency: Frequent (HP:0040282). (ORPHA:99798)
- Agenesis of first permanent molar tooth (HP:0011056): Agenesis of either maxillary first permanent molar or mandibular first permanent molar or both. Evidence: TAS. Frequency: Frequent (HP:0040282). (ORPHA:99798)
- Orofacial cleft (HP:0000202): The presence of a cleft (gap, opening, or groove) in the oral cavity, including cleft of the upper lip and/or cleft of the palate. Cleft of the upper lip is visible as a groove or fissure in the lip, most frequently due to a congenital failure of the maxillary and median nasal processes to fuse. Cleft palate is characterized by a grooved depression or fissure in the roof of the mouth, most often resulting from a congenital failure of the palate to fuse properly. Clefts of the lip and palate can occur individually or together. It is preferable to code each defect separately. Evidence: TAS. Frequency: Occasional (HP:0040283). (ORPHA:99798)
- Taurodontia (HP:0000679): Increased volume of dental pulp of permanent molar characterized by a crown body-root ratio equal or larger than 1:1 or an elongated pulp chambers and apical displacement of the bifurcation or trifurcation of the roots. Evidence: TAS. Frequency: Occasional (HP:0040283). (ORPHA:99798)
- Hypoplasia of teeth (HP:0000685): Developmental hypoplasia of teeth. Evidence: TAS. Frequency: Occasional (HP:0040283). (ORPHA:99798)
- Enamel hypoplasia (HP:0006297): Developmental hypoplasia of the dental enamel. Evidence: TAS. Frequency: Occasional (HP:0040283). (ORPHA:99798)
- Peg-shaped maxillary lateral incisors (HP:0006342): A tooth crown with its mesial and distal sides converging or tapering toward the incisal edge causing severe reduction of mesiodistal diameter. Evidence: TAS. Frequency: Occasional (HP:0040283). (ORPHA:99798)
- Abnormal primary molar morphology (HP:0006344): An abnormality of morphology of primary molar. Evidence: TAS. Frequency: Occasional (HP:0040283). (ORPHA:99798)
- Abnormal dental morphology (HP:0006482): An abnormality of the morphology of the tooth. Evidence: TAS. Frequency: Occasional (HP:0040283). (ORPHA:99798)
- Agenesis of mandibular premolar (HP:0011053): Agenesis of mandibular premolar. Evidence: TAS. Frequency: Occasional (HP:0040283). (ORPHA:99798)
- Abnormality of canine (HP:0011078): An abnormality of canine tooth. Evidence: TAS. Frequency: Occasional (HP:0040283). (ORPHA:99798)
- Short face (HP:0011219): Facial height (length) is more than two standard deviations below the mean (objective); or an apparent decrease in the height (length) of the face (subjective). Evidence: TAS. Frequency: Occasional (HP:0040283). (ORPHA:99798)
- Eclabion (HP:0012472): A turning outward of the lip or lips, that is, eversion of the lips. Evidence: TAS. Frequency: Occasional (HP:0040283). (ORPHA:99798)